Phenotypes associated with the disease intellectual disability, autosomal recessive 11 (OMIM:611097):
- Moderate intellectual disability (HP:0002342): Moderate intellectual disability (ID) is defined as a type of ID characterized by moderately sub-average adaptive functioning and intellectual functioning, with an intelligence quotient (IQ) the range of 35-49. Evidence: TAS. (OMIM:611097)
- Autosomal recessive inheritance (HP:0000007): A mode of inheritance that is observed for traits related to a gene encoded on one of the autosomes (i.e., the human chromosomes 1-22) in which a trait manifests in individuals with two pathogenic alleles, either homozygotes (two copies of the same mutant allele) or compound heterozygotes (whereby each copy of a gene has a distinct mutant allele). Evidence: TAS. (OMIM:611097)